Phenotypes associated with the disease Distal duplication 18q syndrome (ORPHA:1716):
- Cryptorchidism (HP:0000028): Testis in inguinal canal. That is, absence of one or both testes from the scrotum owing to failure of the testis or testes to descend through the inguinal canal to the scrotum. Evidence: TAS. Frequency: Very frequent (HP:0040281). (ORPHA:1716)
- Dolichocephaly (HP:0000268): An abnormality of skull shape characterized by a increased anterior-posterior diameter, i.e., an increased antero-posterior dimension of the skull. Cephalic index less than 76%. Alternatively, an apparently increased antero-posterior length of the head compared to width. Often due to premature closure of the sagittal suture. Evidence: TAS. Frequency: Very frequent (HP:0040281). (ORPHA:1716)
- Round face (HP:0000311): The facial appearance is more circular than usual as viewed from the front. Evidence: TAS. Frequency: Very frequent (HP:0040281). (ORPHA:1716)
- Triangular face (HP:0000325): Facial contour, as viewed from the front, triangular in shape, with breadth at the temples and tapering to a narrow chin. Evidence: TAS. Frequency: Very frequent (HP:0040281). (ORPHA:1716)
- Micrognathia (HP:0000347): Developmental hypoplasia of the mandible. Evidence: TAS. Frequency: Very frequent (HP:0040281). (ORPHA:1716)
- Prominent nasal bridge (HP:0000426): Anterior positioning of the nasal root in comparison to the usual positioning for age. Evidence: TAS. Frequency: Very frequent (HP:0040281). (ORPHA:1716)
- Anteverted nares (HP:0000463): Anteriorly-facing nostrils viewed with the head in the Frankfurt horizontal and the eyes of the observer level with the eyes of the subject. This gives the appearance of an upturned nose (upturned nasal tip). Evidence: TAS. Frequency: Very frequent (HP:0040281). (ORPHA:1716)
- Short neck (HP:0000470): Diminished length of the neck. Evidence: TAS. Frequency: Very frequent (HP:0040281). (ORPHA:1716)
- Thickened nuchal skin fold (HP:0000474): A thickening of the skin thickness in the posterior aspect of the fetal neck. A nuchal fold (NF) measurement is obtained in a transverse section of the fetal head at the level of the cavum septum pellucidum and thalami, angled posteriorly to include the cerebellum. The measurement is taken from the outer edge of the occiput bone to the outer skin limit directly in the midline. An NF measurement greater than 5 mm at 14 to 17+6 weeks of gestation, or 6 mm at 18 to 28 weeks has been associated with a markedly increased risk for Down syndrome. Evidence: TAS. Frequency: Very frequent (HP:0040281). (ORPHA:1716)
- Carious teeth (HP:0000670): Caries is a multifactorial bacterial infection affecting the structure of the tooth. This term has been used to describe the presence of more than expected dental caries. Evidence: TAS. Frequency: Very frequent (HP:0040281). (ORPHA:1716)
- Global developmental delay (HP:0001263): A delay in the achievement of motor or mental milestones in the domains of development of a child, including motor skills, speech and language, cognitive skills, and social and emotional skills. This term should only be used to describe children younger than five years of age. Evidence: TAS. Frequency: Very frequent (HP:0040281). (ORPHA:1716)
- Short nose (HP:0003196): Distance from nasion to subnasale more than two standard deviations below the mean, or alternatively, an apparently decreased length from the nasal root to the nasal tip. Evidence: TAS. Frequency: Very frequent (HP:0040281). (ORPHA:1716)
- Progressive intervertebral space narrowing (HP:0004622): A progressive form of decreased height of the intervertebral disk. Evidence: TAS. Frequency: Very frequent (HP:0040281). (ORPHA:1716)
- Abnormal dental morphology (HP:0006482): An abnormality of the morphology of the tooth. Evidence: TAS. Frequency: Very frequent (HP:0040281). (ORPHA:1716)
- Abnormal hair pattern (HP:0010720): An abnormality of the distribution of hair growth. Evidence: TAS. Frequency: Very frequent (HP:0040281). (ORPHA:1716)
- Cognitive impairment (HP:0100543): Abnormal cognition is characterized by deficits in thinking, reasoning, or remembering. Evidence: TAS. Frequency: Very frequent (HP:0040281). (ORPHA:1716)
- High palate (HP:0000218): Height of the palate more than 2 SD above the mean (objective) or palatal height at the level of the first permanent molar more than twice the height of the teeth (subjective). Evidence: TAS. Frequency: Frequent (HP:0040282). (ORPHA:1716)
- Arachnodactyly (HP:0001166): Abnormally long and slender fingers (spider fingers). Evidence: TAS. Frequency: Frequent (HP:0040282). (ORPHA:1716)
- Abnormal dermatoglyphics (HP:0007477): An abnormality of dermatoglyphs (fingerprints), which are present on fingers, palms, toes, and soles. Evidence: TAS. Frequency: Frequent (HP:0040282). (ORPHA:1716)
- Bilateral single transverse palmar creases (HP:0007598): The distal and proximal transverse palmar creases are merged into a single transverse palmar crease on both hands. Evidence: TAS. Frequency: Frequent (HP:0040282). (ORPHA:1716)
- Hypoplasia of penis (HP:0008736). Evidence: TAS. Frequency: Frequent (HP:0040282). (ORPHA:1716)
- Abnormal cardiovascular system morphology (HP:0030680): Any structural anomaly of the heart and blood vessels. Evidence: TAS. Frequency: Frequent (HP:0040282). (ORPHA:1716)
- Camptodactyly of finger (HP:0100490): The distal interphalangeal joint and/or the proximal interphalangeal joint of the fingers cannot be extended to 180 degrees by either active or passive extension. Evidence: TAS. Frequency: Frequent (HP:0040282). (ORPHA:1716)
- Abnormal female external genitalia morphology (HP:0000055): Any structural abnormality of the female external genitalia. Evidence: TAS. Frequency: Occasional (HP:0040283). (ORPHA:1716)
- Choanal atresia (HP:0000453): Absence or abnormal closure of the choana (the posterior nasal aperture). Most embryologists believe that posterior choanal atresia results from a failure of rupture between the 35th and 38th day of fetal life of the partition which separates the bucconasal or buccopharyngeal membranes. The resultant choanal atresia may be unilateral or bilateral, bony or membranous, complete or incomplete. In over 90 per cent of cases the obstruction is bony, while in the remainder it is membranous. The bony type of atresia is commonly located 1-2 mm. anterior to the posterior edge of the hard palate, and the osseous septum varies in thickness from 1 to 10 mm. In the membranous form of choanal atresia the obstruction usually occurs further posteriorly. In approximately one third of cases the atresia is bilateral. Evidence: TAS. Frequency: Occasional (HP:0040283). (ORPHA:1716)
- Iris coloboma (HP:0000612): A coloboma of the iris. Evidence: TAS. Frequency: Occasional (HP:0040283). (ORPHA:1716)
- Pectus excavatum (HP:0000767): A defect of the chest wall characterized by a depression of the sternum, giving the chest ("pectus") a caved-in ("excavatum") appearance. Evidence: TAS. Frequency: Occasional (HP:0040283). (ORPHA:1716)
- Large hands (HP:0001176). Evidence: TAS. Frequency: Occasional (HP:0040283). (ORPHA:1716)
- Deviation of finger (HP:0004097): Deviated fingers is a term that should be used if one or more fingers of the hand are deviated from their normal position, either to the radial or ulnar side. A deviation of a finger can be caused by an abnormal form of one or more of the phalanges of the affected finger, or by a deviation or displacement of one or more phalanges. Evidence: TAS. Frequency: Occasional (HP:0040283). (ORPHA:1716)
- Clinodactyly of the 5th finger (HP:0004209): Clinodactyly refers to a bending or curvature of the fifth finger in the radial direction (i.e., towards the 4th finger). Evidence: TAS. Frequency: Occasional (HP:0040283). (ORPHA:1716)
- Posteriorly rotated ears (HP:0000358): A type of abnormal location of the ears in which the position of the ears is characterized by posterior rotation (the superior part of the ears is rotated towards the back of the head, and the inferior part of the ears towards the front). Evidence: TAS. Frequency: Very frequent (HP:0040281). (ORPHA:1716)